- Reduced circulating lactate dehydrogenase concentration (HP:0045041): Concentration of lactate dehydrogenase in the blood circulation below the lower limit of normal. Evidence: PCS. (PMID:2334429)
This phenotype is associated with the disease glycogen storage disease due to lactate dehydrogenase H-subunit deficiency (OMIM:614128).